Phenotypes associated with the disease age related macular degeneration 2 (OMIM:153800):
- Macular degeneration (HP:0000608): A nonspecific term denoting degeneration of the retinal pigment epithelium and/or retinal photoreceptor cells of the macula lutea. Evidence: PCS. Onset: Late onset (HP:0003584). (PMID:9295268)
- Autosomal dominant inheritance (HP:0000006): A mode of inheritance that is observed for traits related to a gene encoded on one of the autosomes (i.e., the human chromosomes 1-22) in which a trait manifests in heterozygotes. In the context of medical genetics, an autosomal dominant disorder is caused when a single copy of the mutant allele is present. Males and females are affected equally, and can both transmit the disorder with a risk of 50% for each child of inheriting the mutant allele. Evidence: TAS. (OMIM:153800)